Phenotypes associated with the disease encephalopathy, acute, infection-induced, susceptibility to, 4 (OMIM:614212):
- Encephalopathy (HP:0001298): Encephalopathy is a term that means brain disease, damage, or malfunction. In general, encephalopathy is manifested by an altered mental state. Evidence: IEA. (OMIM:614212)
- Seizure (HP:0001250): A seizure is an intermittent abnormality of nervous system physiology characterized by a transient occurrence of signs and/or symptoms due to abnormal excessive or synchronous neuronal activity in the brain. Evidence: TAS. (OMIM:614212)
- Autosomal recessive inheritance (HP:0000007): A mode of inheritance that is observed for traits related to a gene encoded on one of the autosomes (i.e., the human chromosomes 1-22) in which a trait manifests in individuals with two pathogenic alleles, either homozygotes (two copies of the same mutant allele) or compound heterozygotes (whereby each copy of a gene has a distinct mutant allele). Evidence: TAS. (OMIM:614212)
- Cerebral edema (HP:0002181): Abnormal accumulation of fluid in the brain. Evidence: TAS. (OMIM:614212)
- Fever (HP:0001945): Body temperature elevated above the normal range. Evidence: IEA. (OMIM:614212)
- Autosomal dominant inheritance (HP:0000006): A mode of inheritance that is observed for traits related to a gene encoded on one of the autosomes (i.e., the human chromosomes 1-22) in which a trait manifests in heterozygotes. In the context of medical genetics, an autosomal dominant disorder is caused when a single copy of the mutant allele is present. Males and females are affected equally, and can both transmit the disorder with a risk of 50% for each child of inheriting the mutant allele. Evidence: TAS. (OMIM:614212)
- Coma (HP:0001259): The complete absence of wakefulness and consciousness, which is evident through a lack of response to any form of external stimuli. Evidence: TAS. (OMIM:614212)